- Abnormal abdomen morphology (HP:0001438): A structural abnormality of the abdomen ('belly'), that is, the part of the body between the pelvis and the thorax. Evidence: IEA. (OMIM:137130)
- Autosomal dominant inheritance (HP:0000006): A mode of inheritance that is observed for traits related to a gene encoded on one of the autosomes (i.e., the human chromosomes 1-22) in which a trait manifests in heterozygotes. In the context of medical genetics, an autosomal dominant disorder is caused when a single copy of the mutant allele is present. Males and females are affected equally, and can both transmit the disorder with a risk of 50% for each child of inheriting the mutant allele. Evidence: IEA. (OMIM:137130)
These phenotypes are associated with the disease GASTRIC SNEEZING (OMIM:137130).